- Strabismus (HP:0000486): A misalignment of the eyes so that the visual axes deviate from bifoveal fixation. The classification of strabismus may be based on a number of features including the relative position of the eyes, whether the deviation is latent or manifest, intermittent or constant, concomitant or otherwise and according to the age of onset and the relevance of any associated refractive error. Evidence: PCS. Onset: Congenital onset (HP:0003577). (PMID:29133973)
- Palpebral fissure narrowing on adduction (HP:0000661). Evidence: PCS. (PMID:29133973)
- Impaired convergence (HP:0000619): Reduced ability to turn the eyes inward in order to focus on a nearby object. Evidence: TAS. (OMIM:126800)
- Impaired ocular abduction (HP:0000634): An impaired ability of the eye to move in the outward direction (towards the side of the head). Evidence: PCS. (PMID:12395297)
- Esotropia (HP:0000565): A form of strabismus with one or both eyes turned inward ('crossed') to a relatively severe degree, usually defined as 10 diopters or more. Evidence: PCS. (PMID:29133973)
- Impaired ocular adduction (HP:0000542): Reduced ability to move the eye in the direction of the nose. Evidence: PCS. (PMID:12395297)
- Duane anomaly (HP:0009921): A condition associated with a limitation of the horizontal ocular movement with retraction of the globe and narrowing of the palpebral fissure on adduction. Evidence: PCS. Onset: Congenital onset (HP:0003577). (PMID:29133973)
- Autosomal dominant inheritance (HP:0000006): A mode of inheritance that is observed for traits related to a gene encoded on one of the autosomes (i.e., the human chromosomes 1-22) in which a trait manifests in heterozygotes. In the context of medical genetics, an autosomal dominant disorder is caused when a single copy of the mutant allele is present. Males and females are affected equally, and can both transmit the disorder with a risk of 50% for each child of inheriting the mutant allele. Evidence: PCS. (PMID:9781021)
These phenotypes are associated with the disease Duane syndrome type 1 (OMIM:126800).